- Cavum septum pellucidum (HP:0002389): If the two laminae of the septum pellucidum are not fused then a fluid-filled space or cavum is present. The cavum septum pellucidum is present at birth but usually obliterates by the age of 3 to 6 months. It is up to 1cm in width and the walls are parallel. It is an enclosed space and is not part of the ventricular system or connected with the subarachnoid space. Evidence: PCS. Frequency: 1/3. (PMID:38815585)
- Strabismus (HP:0000486): A misalignment of the eyes so that the visual axes deviate from bifoveal fixation. The classification of strabismus may be based on a number of features including the relative position of the eyes, whether the deviation is latent or manifest, intermittent or constant, concomitant or otherwise and according to the age of onset and the relevance of any associated refractive error. Evidence: PCS. Frequency: 4/23. (PMID:38815585)
- Short stature (HP:0004322): A height below that which is expected according to age and gender norms. Although there is no universally accepted definition of short stature, many refer to "short stature" as height more than 2 standard deviations below the mean for age and gender (or below the 3rd percentile for age and gender dependent norms). Evidence: PCS. Frequency: 0/18. (PMID:38815585)
- Focal impaired awareness seizure (HP:0002384): Focal impaired awareness seizure (or focal seizure with impaired or lost awareness) is a type of focal-onset seizure characterized by some degree (which may be partial) of impairment of the person's awareness of themselves or their surroundings at any point during the seizure. Evidence: PCS. Frequency: 1/1. (PMID:38815585)
- Snoring (HP:0025267): Deep, noisy breathing during sleep, accompanied by hoarse or harsh sounds, is caused by the vibration of respiratory structures, especially the soft palate. This vibration results in sound due to obstructed air movement during breathing while sleeping. Evidence: PCS. Frequency: 1/1. (PMID:38815585)
- Generalized hypotonia (HP:0001290): Generalized muscular hypotonia (abnormally low muscle tone). Evidence: PCS. Frequency: 1/1. (PMID:38815585)
- Elevated circulating creatine kinase MM isoform concentration (HP:0032234): The concentration of creatine kinase MM isoform in the blood circulation is above the upper limit of normal. Evidence: PCS. Frequency: 0/1. (PMID:38702431)
- Unilateral cryptorchidism (HP:0012741): Absence of a testis from the scrotum on one side owing to failure of the testis or testes to descend through the inguinal canal to the scrotum. Evidence: PCS. Frequency: 1/1. (PMID:38815585)
- Thin corpus callosum (HP:0033725): An abnormally thin corpus callous, due to atrophy, hypoplasia or agenesis. This term is intended to be used in situations where it is not known if thinning of the corpus callosum (for instance, as visualized by magnetic resonance tomography) is due to abnormal development (e.g. a leukodystrophy) or atrophy following normal development (e.g. neurodegeneration). Evidence: PCS. Frequency: 1/1. (PMID:38815585)
- Cataract (HP:0000518): A cataract is an opacity or clouding that develops in the crystalline lens of the eye or in its capsule. Evidence: PCS. Frequency: 1/1. (PMID:38815585)
- Ankyloglossia (HP:0010296): Short or anteriorly attached lingual frenulum, associated with limited mobility of the tongue. Evidence: PCS. Frequency: 1/25. (PMID:38815585)
- Hyperactivity (HP:0000752): Hyperactivity is a condition characterized by constant and unusually high levels of activity, even in situations where it is deemed inappropriate. Evidence: PCS. Frequency: 1/1. (PMID:38815585)
- Constipation (HP:0002019): Infrequent or difficult evacuation of feces. Evidence: PCS. Frequency: 1/1. (PMID:38815585)
- Posteriorly rotated ears (HP:0000358): A type of abnormal location of the ears in which the position of the ears is characterized by posterior rotation (the superior part of the ears is rotated towards the back of the head, and the inferior part of the ears towards the front). Evidence: PCS. Frequency: 5/25. (PMID:38815585)
- Neonatal onset (HP:0003623): Onset of signs or symptoms of disease within the first 28 days of life. Evidence: PCS. Frequency: 2/3. (PMID:38702431)
- Incoordination (HP:0002311): A deficit in coordination of muscle movements. Coordination is defined as the orchestrated movement of multiple body parts as required to accomplish intended actions, like walking. Evidence: PCS. Frequency: 1/1. (PMID:38815585)
- Downslanted palpebral fissures (HP:0000494): The palpebral fissure inclination is more than two standard deviations below the mean. Evidence: PCS. Frequency: 8/27. (PMID:38815585;PMID:38702431)
- Clumsiness (HP:0002312): Lack of physical coordination resulting in an abnormal tendency to drop items or bump into objects. Evidence: PCS. Frequency: 1/1. (PMID:38815585)
- Microcephaly (HP:0000252): Head circumference below 2 standard deviations below the mean for age and gender. Evidence: PCS. Frequency: 3/16. (PMID:38815585)
- Tall stature (HP:0000098): A height above that which is expected according to age and gender norms. Evidence: PCS. Frequency: 1/1. (PMID:38815585)
- Deeply set eye (HP:0000490): An eye that is more deeply recessed into the plane of the face than is typical. Evidence: PCS. Frequency: 11/25. (PMID:38815585)
- Cerebral palsy (HP:0100021): Cerebral palsy describes a group of permanent disorders of the development of movement and posture, causing activity limitation, that are attributed to nonprogressive disturbances that occurred in the developing fetal or infant brain. The motor disorders of cerebral palsy are often accompanied by disturbances of sensation, perception, cognition, communication, and behavior, by epilepsy, and by secondary musculoskeletal problems. Evidence: PCS. Frequency: 1/1. (PMID:38815585)
- Midface retrusion (HP:0011800): Posterior positions and/or vertical shortening of the infraorbital and perialar regions, or increased concavity of the face and/or reduced nasolabial angle. Evidence: PCS. Frequency: 1/25. (PMID:38815585)
- High myopia (HP:0011003): A severe form of myopia with greater than -6.00 diopters. Evidence: PCS. Frequency: 1/1. (PMID:38815585)
- Recurrent hand flapping (HP:0100023): A type of repetitive behavior in which the affected individual repeatedly waves the hands and/or arms rhythmically. Evidence: PCS. Frequency: 2/5. (PMID:38815585)
- Epileptic spasm (HP:0011097): A sudden flexion, extension, or mixed extension-flexion of predominantly proximal and truncal muscles that is usually more sustained than a myoclonic movement but not as sustained as a tonic seizure. Limited forms may occur: Grimacing, head nodding, or subtle eye movements. Epileptic spasms frequently occur in clusters. Infantile spasms are the best known form, but spasms can occur at all ages. Evidence: PCS. Frequency: 1/1. (PMID:38815585)
- Pectus excavatum (HP:0000767): A defect of the chest wall characterized by a depression of the sternum, giving the chest ("pectus") a caved-in ("excavatum") appearance. Evidence: PCS. Frequency: 4/28. (PMID:38815585;PMID:38702431)
- Drooling (HP:0002307): Habitual flow of saliva out of the mouth. Evidence: PCS. Frequency: 1/1. (PMID:38815585)
- Thoracic scoliosis (HP:0002943). Evidence: PCS. Frequency: 1/1. (PMID:38702431)
- Low-set ears (HP:0000369): Upper insertion of the ear to the scalp below an imaginary horizontal line drawn between the inner canthi of the eye and extending posteriorly to the ear. Evidence: PCS. Frequency: 7/27. (PMID:38815585;PMID:38702431)
- Autosomal dominant inheritance (HP:0000006): A mode of inheritance that is observed for traits related to a gene encoded on one of the autosomes (i.e., the human chromosomes 1-22) in which a trait manifests in heterozygotes. In the context of medical genetics, an autosomal dominant disorder is caused when a single copy of the mutant allele is present. Males and females are affected equally, and can both transmit the disorder with a risk of 50% for each child of inheriting the mutant allele. Evidence: PCS. (PMID:38815585)
- Asthenia (HP:0025406): A state characterized by a feeling of weakness and loss of strength leading to a generalized weakness of the body. Evidence: PCS. Frequency: 1/4. (PMID:38815585;PMID:38702431)
- Narrow forehead (HP:0000341): Width of the forehead or distance between the frontotemporales is more than two standard deviations below the mean (objective); or apparently narrow intertemporal region (subjective). Evidence: PCS. Frequency: 4/25. (PMID:38815585)
- Upslanted palpebral fissure (HP:0000582): The palpebral fissure inclination is more than two standard deviations above the mean for age (objective); or, the inclination of the palpebral fissure is greater than typical for age. Evidence: PCS. Frequency: 1/25. (PMID:38815585)
- Hypsarrhythmia (HP:0002521): Hypsarrhythmia is abnormal interictal high amplitude waves and a background of irregular spikes. There is continuous (during wakefulness), high-amplitude (>200 Hz), generalized polymorphic slowing with no organized background and multifocal spikes demonstrated by electroencephalography (EEG). Evidence: PCS. Frequency: 1/1. (PMID:38815585)
- Cerebellar atrophy (HP:0001272): Cerebellar atrophy is defined as a cerebellum with initially normal structures, in a posterior fossa with normal size, which displays enlarged fissures (interfolial spaces) in comparison to the foliae secondary to loss of tissue. Cerebellar atrophy implies irreversible loss of tissue and result from an ongoing progressive disease until a final stage is reached or a single injury, e.g. an intoxication or infectious event. Evidence: PCS. Frequency: 1/1. (PMID:38702431)
- Motor delay (HP:0001270): A type of Developmental delay characterized by a delay in acquiring motor skills. Evidence: PCS. Frequency: 4/4. (PMID:38815585;PMID:38702431)
- Anxiety (HP:0000739): Intense feelings of nervousness, tension, or panic often arise in response to interpersonal stresses. There is worry about the negative effects of past unpleasant experiences and future negative possibilities. Individuals may feel fearful, apprehensive, or threatened by uncertainty, and they may also have fears of falling apart or losing control. Evidence: PCS. Frequency: 3/5. (PMID:38815585;PMID:38702431)
- Motor stereotypy (HP:0000733): Use of the same abnormal action in response to certain triggers or at random. They may be used as a way to regulate one's internal state but must otherwise have no apparent functional purpose. Evidence: PCS. Frequency: 1/1. (PMID:38815585)
- Hallux valgus (HP:0001822): Lateral deviation of the great toe (i.e., in the direction of the little toe). Evidence: PCS. Frequency: 1/1. (PMID:38815585)
- High palate (HP:0000218): Height of the palate more than 2 SD above the mean (objective) or palatal height at the level of the first permanent molar more than twice the height of the teeth (subjective). Evidence: PCS. Frequency: 1/25. (PMID:38815585)
- Wide intermamillary distance (HP:0006610): A larger than usual distance between the left and right nipple. Evidence: PCS. Frequency: 2/25. (PMID:38815585)
- Exotropia (HP:0000577): A form of strabismus with one or both eyes deviated outward. Evidence: PCS. Frequency: 2/6. (PMID:38815585)
- Sleep terror (HP:0030765): Autonomic arousal, screaming, sweating, crying, outbursts during sleep, usually no recollection at the individual level; typically observed by others. Evidence: PCS. Frequency: 1/1. (PMID:38815585)
- Dysphagia (HP:0002015): Difficulty in swallowing. Evidence: PCS. Frequency: 1/1. (PMID:38815585)
- Delayed speech and language development (HP:0000750): A degree of language development that is significantly below the norm for a child of a specified age. Evidence: PCS. Frequency: 3/4. (PMID:38815585;PMID:38702431)
- Scoliosis (HP:0002650): The presence of an abnormal lateral curvature of the spine. Evidence: PCS. Frequency: 1/1. (PMID:38815585)
- Atopic dermatitis (HP:0001047): Atopic dermatitis (AD) or atopic eczema is an itchy, inflammatory skin condition with a predilection for the skin flexures. It is characterized by poorly defined erythema with edema, vesicles, and weeping in the acute stage and skin thickening (lichenification) in the chronic stage. Evidence: PCS. Frequency: 2/2. (PMID:38815585)
- Thin vermilion border (HP:0000233): Height of the vermilion of the medial part of the lip more than 2 SD below the mean, or apparently reduced height of the vermilion of the lip in the frontal view. The vermilion is the red part of the lips (and confusingly, the vermilion itself is also often referred to as being equivalent the lips). Evidence: PCS. Frequency: 3/25. (PMID:38815585)
- Developmental regression (HP:0002376): Loss of developmental skills, as manifested by loss of developmental milestones. Evidence: PCS. Frequency: 1/1. (PMID:38815585)
- Febrile seizure (within the age range of 3 months to 6 years) (HP:0002373): A febrile seizure is any type of seizure (most often a generalized tonic-clonic seizure) occurring with fever (at least 38 degrees Celsius) but in the absence of central nervous system infection, severe metabolic disturbance or other alternative precipitant in children between the ages of 3 months and 6 years. Evidence: PCS. Frequency: 1/1. (PMID:38815585)
- Bifid uvula (HP:0000193): Uvula separated into two parts most easily seen at the tip. Evidence: PCS. Frequency: 1/25. (PMID:38815585)
- Inverted nipples (HP:0003186): The presence of nipples that instead of pointing outward are retracted inwards. Evidence: PCS. Frequency: 2/25. (PMID:38815585)
- Periventricular nodular heterotopia (HP:0032388): Nodules of heterotopia along the ventricular walls. There can be a single nodule or a large number of nodules, they can exist on either or both sides of the brain at any point along the higher ventricle margins, they can be small or large, single or multiple. Evidence: PCS. Frequency: 1/3. (PMID:38815585)
- Bilateral tonic-clonic seizure with generalized onset (HP:0025190): A bilateral tonic-clonic seizure with generalized onset is a type of bilateral tonic-clonic seizure characterized by generalized onset; these seizures rapidly engage networks in both hemispheres at the start of the seizure. Evidence: PCS. Frequency: 1/1. (PMID:38815585)
- Self-injurious behavior (HP:0100716): Self-aggression. Evidence: PCS. Frequency: 2/3. (PMID:38702431)
- Epileptic encephalopathy (HP:0200134): A condition in which epileptiform abnormalities are believed to contribute to the progressive disturbance in cerebral function. Epileptic encephalaopathy is characterized by (1) electrographic EEG paroxysmal activity that is often aggressive, (2) seizures that are usually multiform and intractable, (3) cognitive, behavioral and neurological deficits that may be relentless, and (4) sometimes early death. Evidence: PCS. Frequency: 1/1. (PMID:38815585)
- Frontal bossing (HP:0002007): Bilateral bulging of the lateral frontal bone prominences with relative sparing of the midline. Evidence: PCS. Frequency: 1/6. (PMID:38815585)
- Webbed neck (HP:0000465): Pterygium colli is a congenital skin fold that runs along the sides of the neck down to the shoulders. It involves an ectopic fibrotic facial band superficial to the trapezius muscle. Excess hair-bearing skin is also present and extends down the cervical region well beyond the normal hairline. Evidence: PCS. Frequency: 1/3. (PMID:38702431)
- Micrognathia (HP:0000347): Developmental hypoplasia of the mandible. Evidence: PCS. Frequency: 2/2. (PMID:38702431)
- Polymicrogyria (HP:0002126): Polymicrogyria is a congenital malformation of the cerebral cortex characterized by abnormal cortical layering (lamination) and an excessive number of small gyri (folds). Evidence: PCS. Frequency: 1/3. (PMID:38815585)
- Epicanthus (HP:0000286): A fold of skin starting above the medial aspect of the upper eyelid and arching downward to cover, pass in front of and lateral to the medial canthus. Evidence: PCS. Frequency: 3/26. (PMID:38815585;PMID:38702431)
- Echolalia (HP:0010529): Echolalia is the automatic imitative repetition of sounds, words, or phrases in the absence of explicit awareness. The repeated words or phrases are typically odd or used in a non-social manner. These can be words or phrases that the affected individual has heard or invented. Evidence: PCS. Frequency: 2/5. (PMID:38815585)
- Moderate intellectual disability (HP:0002342): Moderate intellectual disability (ID) is defined as a type of ID characterized by moderately sub-average adaptive functioning and intellectual functioning, with an intelligence quotient (IQ) the range of 35-49. Evidence: PCS. Frequency: 1/1. (PMID:38815585)
- Delayed CNS myelination (HP:0002188): Delayed myelination in the central nervous system. Evidence: PCS. Frequency: 1/1. (PMID:38815585)
- Dermal translucency (HP:0010648): An abnormally increased ability of the skin to permit light to pass through (translucency) such that subcutaneous structures such as veins display an increased degree of visibility. Evidence: PCS. Frequency: 3/25. (PMID:38815585)
- Seizure (HP:0001250): A seizure is an intermittent abnormality of nervous system physiology characterized by a transient occurrence of signs and/or symptoms due to abnormal excessive or synchronous neuronal activity in the brain. Evidence: PCS. Frequency: 1/3. (PMID:38702431)
- Gait ataxia (HP:0002066): A type of ataxia characterized by the impairment of the ability to coordinate the movements required for normal walking. Gait ataxia is characteirzed by a wide-based staggering gait with a tendency to fall. Evidence: PCS. Frequency: 1/1. (PMID:38815585)
- Hypotonia (HP:0001252): Hypotonia is an abnormally low muscle tone (the amount of tension or resistance to movement in a muscle). Even when relaxed, muscles have a continuous and passive partial contraction which provides some resistance to passive stretching. Hypotonia thus manifests as diminished resistance to passive stretching. Hypotonia is not the same as muscle weakness, although the two conditions can co-exist. Evidence: PCS. Frequency: 4/4. (PMID:38815585;PMID:38702431)
- Myoclonic seizure (HP:0032794): A myoclonic seizure is a type of motor seizure characterized by sudden, brief (<100 ms) involuntary single or multiple contraction of muscles or muscle groups of variable topography (axial, proximal limb, distal). Myoclonus is less regularly repetitive and less sustained than is clonus. Evidence: PCS. Frequency: 2/2. (PMID:38815585)
- Smooth philtrum (HP:0000319): Flat skin surface, with no ridge formation in the central region of the upper lip between the nasal base and upper vermilion border. Evidence: PCS. Frequency: 1/1. (PMID:38702431)
- Aggressive behavior (HP:0000718): Behavior or an act aimed at harming a person, animal, or physical property (e.g., acts of physical violence; shouting, swearing, and using harsh language; slashing someone's tires). Evidence: PCS. Frequency: 3/8. (PMID:38815585;PMID:38702431)
- Autism (HP:0000717): Autism is a neurodevelopmental disorder characterized by impaired social interaction and communication, and by restricted and repetitive behavior. Autism begins in childhood. It is marked by the presence of markedly abnormal or impaired development in social interaction and communication and a markedly restricted repertoire of activity and interest. Manifestations of the disorder vary greatly depending on the developmental level and chronological age of the individual (DSM-IV). Evidence: PCS. Frequency: 4/4. (PMID:38815585;PMID:38702431)
- Anger (HP:0031473): A state of excessive negative emotional reactivity characterized by strong feelings of hostility or antagonism typically in response to perceived provocation. It is often accompanied by physiological arousal (e.g., increased heart rate, muscle tension, or activation of the sympathetic nervous system) and expressions of blame, perceived injustice, or judgment. The experience of anger may be directed outwardly toward individuals, groups, objects, or abstract entities, or inwardly toward oneself. Evidence: PCS. Frequency: 1/4. (PMID:38815585)
- Fetal onset (HP:0011461): Onset prior to birth but after 8 weeks of embryonic development (corresponding to a gestational age of 10 weeks). Evidence: PCS. Frequency: 1/3. (PMID:38702431)
- Hypertelorism (HP:0000316): Interpupillary distance more than 2 SD above the mean (alternatively, the appearance of an increased interpupillary distance or widely spaced eyes). Evidence: PCS. Frequency: 1/1. (PMID:38702431)
- Patent ductus arteriosus (HP:0001643): In utero, the ductus arteriosus (DA) serves to divert ventricular output away from the lungs and toward the placenta by connecting the main pulmonary artery to the descending aorta. A patent ductus arteriosus (PDA) in the first 3 days of life is a physiologic shunt in healthy term and preterm newborn infants, and normally is substantially closed within about 24 hours after bith and completely closed after about three weeks. Failure of physiologcal closure is referred to a persistent or patent ductus arteriosus (PDA). Depending on the degree of left-to-right shunting, PDA can have clinical consequences. Evidence: PCS. Frequency: 1/1. (PMID:38815585)
- Pes planus (HP:0001763): A foot where the longitudinal arch of the foot is in contact with the ground or floor when the individual is standing; or, in a patient lying supine, a foot where the arch is in contact with the surface of a flat board pressed against the sole of the foot by the examiner with a pressure similar to that expected from weight bearing; or, the height of the arch is reduced. Evidence: PCS. Frequency: 1/25. (PMID:38815585)
- Retrognathia (HP:0000278): An abnormality in which the mandible is mislocalised posteriorly. Evidence: PCS. Frequency: 4/25. (PMID:38815585)
- Intellectual disability (HP:0001249): The term intellectual disability or intellectual developmental disorder is used to describe significantly sub-average intellectual and adaptive functioning based on clinical assessment and as measured by individually administered, appropriately normed, standardized and validated tests of intellectual functioning and adaptive behavior, with onset during the developmental period from infancy through adolescence. Evidence: PCS. Frequency: 14/16. (PMID:38815585;PMID:38702431)
- Exercise intolerance (HP:0003546): A functional motor deficit where individuals whose responses to the challenges of exercise fail to achieve levels considered normal for their age and gender. Evidence: PCS. Frequency: 1/1. (PMID:38702431)
- Spastic diplegia (HP:0001264): Spasticity (neuromuscular hypertonia) primarily in the muscles of the legs, hips, and pelvis. Evidence: PCS. Frequency: 1/1. (PMID:38815585)
- EEG abnormality (HP:0002353): Abnormality observed by electroencephalogram (EEG), which is used to record of the brain's spontaneous electrical activity from multiple electrodes placed on the scalp. Evidence: PCS. Frequency: 5/10. (PMID:38815585;PMID:38702431)
- Expressive language delay (HP:0002474): A delay in the acquisition of the ability to use language to communicate needs, wishes, or thoughts. Evidence: PCS. Frequency: 1/4. (PMID:38815585)
- Obstructive sleep apnea (HP:0002870): Obstructive Sleep Apnea is a condition characterized by the obstruction of the airway and pauses in breathing during sleep, which occur multiple times throughout the night. It is related to the relaxation of muscle tone that typically happens during sleep, leading to a partial collapse of the soft tissues in the airway and causing airflow obstruction. Evidence: PCS. Frequency: 2/2. (PMID:38815585)
- Joint hypermobility (HP:0001382): The capability that a joint (or a group of joints) has to move, passively and/or actively, beyond normal limits along physiological axes. Evidence: PCS. Frequency: 4/15. (PMID:38815585;PMID:38702431)
- Feeding difficulties (HP:0011968): Impaired ability to eat related to problems gathering food and getting ready to suck, chew, or swallow it. Evidence: PCS. Frequency: 2/2. (PMID:38702431)
- Global developmental delay (HP:0001263): A delay in the achievement of motor or mental milestones in the domains of development of a child, including motor skills, speech and language, cognitive skills, and social and emotional skills. This term should only be used to describe children younger than five years of age. Evidence: PCS. Frequency: 13/14. (PMID:38815585;PMID:38702431)
- Delayed gross motor development (HP:0002194): A type of motor delay characterized by a delay in acquiring the ability to control the large muscles of the body for walking, running, sitting, and crawling. Evidence: PCS. Frequency: 1/1. (PMID:38815585)
- Schizencephaly (HP:0010636): The presence of a cleft in the cerebral cortex unilaterally or bilaterally, usually located in the frontal area. Evidence: PCS. Frequency: 1/3. (PMID:38815585)
- Abnormal fontanelle morphology (HP:0011328): An abnormality of the fontanelle. Evidence: PCS. Frequency: 2/25. (PMID:38815585)
- Autistic behavior (HP:0000729): Persistent deficits in social interaction and communication and interaction as well as a markedly restricted repertoire of activity and interest as well as repetitive patterns of behavior. Evidence: PCS. Frequency: 3/7. (PMID:38815585;PMID:38702431)
- Microphthalmia (HP:0000568): A developmental anomaly characterized by abnormal smallness of one or both eyes. Evidence: PCS. Frequency: 1/25. (PMID:38815585)
- Hypotelorism (HP:0000601): Interpupillary distance less than 2 SD below the mean (alternatively, the appearance of an decreased interpupillary distance or closely spaced eyes). Evidence: PCS. Frequency: 2/25. (PMID:38815585)
- Broad philtrum (HP:0000289): Distance between the philtral ridges, measured just above the vermilion border, more than 2 standard deviations above the mean, or alternatively, an apparently increased distance between the ridges of the philtrum. Evidence: PCS. Frequency: 1/1. (PMID:38702431)
- Sacral dimple (HP:0000960): A cutaneous indentation resulting from tethering of the skin to underlying structures (bone) of the intergluteal cleft. Evidence: PCS. Frequency: 1/25. (PMID:38815585)
- Hypospadias (HP:0000047): Abnormal position of urethral meatus on the ventral penile shaft (underside) characterized by displacement of the urethral meatus from the tip of the glans penis to the ventral surface of the penis, scrotum, or perineum. Evidence: PCS. Frequency: 1/1. (PMID:38815585)
- Triangular face (HP:0000325): Facial contour, as viewed from the front, triangular in shape, with breadth at the temples and tapering to a narrow chin. Evidence: PCS. Frequency: 1/25. (PMID:38815585)
- Apnea (HP:0002104): Lack of breathing with no movement of the respiratory muscles and no exchange of air in the lungs. This term refers to a disposition to have recurrent episodes of apnea rather than to a single event. Evidence: PCS. Frequency: 2/2. (PMID:38815585)
- Clonus (HP:0002169): A series of rhythmic and involuntary muscle contractions (at a frequency of about 5 to 7 Hz) that occur in response to an abruptly applied and sustained stretch. Evidence: PCS. Frequency: 1/1. (PMID:38815585)
- Abnormal calvaria morphology (HP:0002683): Abnormality of the morphology (structure) of the calvaria (skullcap), that is, of that part of the skull that is made up of the superior portions of the frontal bone, occipital bone, and parietal bones and covers the cranial cavity that contains the brain. Evidence: PCS. Frequency: 5/23. (PMID:38815585)
- Inguinal hernia (HP:0000023): Protrusion of the contents of the abdominal cavity through the inguinal canal. Evidence: PCS. Frequency: 2/25. (PMID:38815585)
- Hypermetropia (HP:0000540): An abnormality of refraction characterized by the ability to see objects in the distance clearly, while objects nearby appear blurry. Evidence: PCS. Frequency: 1/1. (PMID:38815585)
- Receptive language delay (HP:0010863): A delay in the acquisition of the ability to understand the speech of others. Evidence: PCS. Frequency: 1/1. (PMID:38815585)
- Narrow jaw (HP:0012801): Bigonial distance (lower facial width) more than 2 standard deviations below the mean (objective); or an apparently decreased width of the lower jaw (mandible) when viewed from the front (subjective). Evidence: PCS. Frequency: 1/1. (PMID:38815585)
- Anteverted ears (HP:0040080). Evidence: PCS. Frequency: 1/25. (PMID:38815585)
- Oppositional defiant disorder (HP:0010865): An enduring pattern of uncooperative, defiant, and hostile behavior towards authority figures that does not involve major antisocial violations, is not accounted for by the child's developmental stage, and results in significant functional impairment. A certain level of oppositional behavior is common in children and adolescents. Evidence: PCS. Frequency: 1/1. (PMID:38815585)
- Downturned corners of mouth (HP:0002714): A morphological abnormality of the mouth in which the angle of the mouth is downturned. The oral commissures are positioned inferior to the midline labial fissure. Evidence: PCS. Frequency: 1/25. (PMID:38815585)
- Macular hypoplasia (HP:0001104): Underdevelopment of the macula lutea. Evidence: PCS. Frequency: 2/25. (PMID:38815585)
- Macrocephaly (HP:0000256): Occipitofrontal (head) circumference greater than 97th centile compared to appropriate, age matched, sex-matched normal standards. Alternatively, a apparently increased size of the cranium. Evidence: PCS. Frequency: 1/16. (PMID:38815585)
- Axial hypotonia (HP:0008936): Muscular hypotonia (abnormally low muscle tone) affecting the musculature of the trunk. Evidence: PCS. Frequency: 1/1. (PMID:38815585)
- Long face (HP:0000276): Facial height (length) is more than 2 standard deviations above the mean (objective); or, an apparent increase in the height (length) of the face (subjective). Evidence: PCS. Frequency: 3/25. (PMID:38815585)
- Spinning (HP:5200069): An excessive frequency of spinning one's body. Evidence: PCS. Frequency: 1/4. (PMID:38815585)
- EEG with burst suppression (HP:0010851): The burst suppression pattern in electroencephalography refers to a characteristic periodic pattern of low voltage (<10 microvolts) suppressed background and a relatively shorter pattern of higher amplitude slow, sharp, and spiking complexes. Evidence: PCS. Frequency: 1/1. (PMID:38815585)
- Extra-axial cerebrospinal fluid accumulation (HP:0012510): An increased amount of cerebrospinal fluid (CSF) in the subarachnoid space. Evidence: PCS. Frequency: 3/3. (PMID:38815585)
- Myoclonic absence seizure (HP:0011150): Myoclonic absence seizure is a type of generalized non-motor (absence) seizure characterized by an interruption of ongoing activities, a blank stare and rhythmic three-per-second myoclonic movements, causing ratcheting abduction of the upper limbs leading to progressive arm elevation, and associated with 3 Hz generalized spike-wave discharges on the electroencephalogram. Duration is typically 10-60 s. Whilst impairment of consciousness may not be obvious the ILAE classified this seizure as a generalized non-motor seizure in 2017. Evidence: PCS. Frequency: 1/1. (PMID:38815585)
- Motor regression (HP:0033044): Loss of previously achieved motor skills, as manifested by loss of developmental motor milestones. Evidence: PCS. Frequency: 1/3. (PMID:38702431)
- Abnormal facial shape (HP:0001999): An abnormal morphology (form) of the face or its components. Evidence: PCS. Frequency: 0/1. (PMID:38702431)
- Hypothyroidism (HP:0000821): Deficiency of thyroid hormone. Evidence: PCS. Frequency: 1/1. (PMID:38815585)
- Plagiocephaly (HP:0001357): Asymmetric head shape, which is usually a combination of unilateral occipital flattening with ipsilateral frontal prominence, leading to rhomboid cranial shape. Evidence: PCS. Frequency: 1/1. (PMID:38815585)
- Growth delay (HP:0001510): A deficiency or slowing down of growth pre- and postnatally. Evidence: PCS. Frequency: 0/3. (PMID:38702431)
- Myopia (HP:0000545): An abnormality of refraction characterized by the ability to see objects nearby clearly, while objects in the distance appear blurry. Evidence: PCS. Frequency: 2/2. (PMID:38815585)
- Obesity (HP:0001513): Accumulation of substantial excess body fat. Evidence: PCS. Frequency: 1/1. (PMID:38815585)
- Cryptorchidism (HP:0000028): Testis in inguinal canal. That is, absence of one or both testes from the scrotum owing to failure of the testis or testes to descend through the inguinal canal to the scrotum. Evidence: PCS. Frequency: 1/1. (PMID:38815585)
- Slender finger (HP:0001238): Fingers that are disproportionately narrow (reduced girth) for the hand/foot size or build of the individual. Evidence: PCS. Frequency: 1/25. (PMID:38815585)
These phenotypes are associated with the disease Karayol-Borroto-Haghshenas neurodevelopmental syndrome (OMIM:620985).